- Hearing impairment (HP:0000365): A decreased magnitude of the sensory perception of sound. Evidence: PCS. Frequency: 1/3. (PMID:22426308;PMID:23906836)
- Delayed eruption of teeth (HP:0000684): Delayed tooth eruption, which can be defined as tooth eruption more than 2 SD beyond the mean eruption age. Evidence: PCS. Frequency: 2/2. (PMID:22426308)
- Strabismus (HP:0000486): A misalignment of the eyes so that the visual axes deviate from bifoveal fixation. The classification of strabismus may be based on a number of features including the relative position of the eyes, whether the deviation is latent or manifest, intermittent or constant, concomitant or otherwise and according to the age of onset and the relevance of any associated refractive error. Evidence: PCS. Frequency: 1/1. (PMID:23906836)
- Short stature (HP:0004322): A height below that which is expected according to age and gender norms. Although there is no universally accepted definition of short stature, many refer to "short stature" as height more than 2 standard deviations below the mean for age and gender (or below the 3rd percentile for age and gender dependent norms). Evidence: PCS. Frequency: 2/3. (PMID:22426308)
- Seizure (HP:0001250): A seizure is an intermittent abnormality of nervous system physiology characterized by a transient occurrence of signs and/or symptoms due to abnormal excessive or synchronous neuronal activity in the brain. Evidence: PCS. Frequency: 1/3. (PMID:22426308;PMID:23906836)
- Hypotonia (HP:0001252): Hypotonia is an abnormally low muscle tone (the amount of tension or resistance to movement in a muscle). Even when relaxed, muscles have a continuous and passive partial contraction which provides some resistance to passive stretching. Hypotonia thus manifests as diminished resistance to passive stretching. Hypotonia is not the same as muscle weakness, although the two conditions can co-exist. Evidence: PCS. Frequency: 3/4. (PMID:22426308;PMID:23906836)
- Coarse facial features (HP:0000280): Absence of fine and sharp appearance of brows, nose, lips, mouth, and chin, usually because of rounded and heavy features or thickened skin with or without thickening of subcutaneous and bony tissues. Evidence: PCS. Frequency: 4/4. (PMID:22426308;PMID:23906836)
- Thick vermilion border (HP:0012471): Increased width of the skin of vermilion border region of upper lip. Evidence: PCS. Frequency: 3/3. (PMID:22426308)
- Macroglossia (HP:0000158): Increased length and width of the tongue. Evidence: PCS. Frequency: 1/4. (PMID:22426308;PMID:23906836)
- Hyperactivity (HP:0000752): Hyperactivity is a condition characterized by constant and unusually high levels of activity, even in situations where it is deemed inappropriate. Evidence: PCS. Frequency: 1/1. (PMID:23906836)
- Intellectual disability (HP:0001249): The term intellectual disability or intellectual developmental disorder is used to describe significantly sub-average intellectual and adaptive functioning based on clinical assessment and as measured by individually administered, appropriately normed, standardized and validated tests of intellectual functioning and adaptive behavior, with onset during the developmental period from infancy through adolescence. Evidence: PCS. Frequency: 1/1. (PMID:23906836)
- Hirsutism (HP:0001007): Abnormally increased hair growth referring to a male pattern of body hair (androgenic hair). Evidence: PCS. Frequency: 3/3. (PMID:22426308)
- Microcephaly (HP:0000252): Head circumference below 2 standard deviations below the mean for age and gender. Evidence: PCS. Frequency: 1/3. (PMID:22426308)
- Cleft palate (HP:0000175): Cleft palate is a developmental defect of the palate resulting from a failure of fusion of the palatine processes and manifesting as a separation of the roof of the mouth (soft and hard palate). Evidence: PCS. Frequency: 2/3. Onset: Congenital onset (HP:0003577). (PMID:22426308)
- Cleft palate (HP:0000175): Cleft palate is a developmental defect of the palate resulting from a failure of fusion of the palatine processes and manifesting as a separation of the roof of the mouth (soft and hard palate). Evidence: PCS. Frequency: 0/1. (PMID:23906836)
- Thick eyebrow (HP:0000574): Increased density/number and/or increased diameter of eyebrow hairs. Evidence: PCS. Frequency: 3/4. (PMID:22426308;PMID:23906836)
- Delayed skeletal maturation (HP:0002750): A decreased rate of skeletal maturation. Delayed skeletal maturation can be diagnosed on the basis of an estimation of the bone age from radiographs of specific bones in the human body. Evidence: PCS. Frequency: 2/3. (PMID:22426308;PMID:23906836)
- Feeding difficulties (HP:0011968): Impaired ability to eat related to problems gathering food and getting ready to suck, chew, or swallow it. Evidence: PCS. Frequency: 3/3. (PMID:22426308)
- Poor suck (HP:0002033): An inadequate sucking reflex, resulting in the difficult of newborns to be breast-fed. Evidence: PCS. Frequency: 3/3. (PMID:22426308)
- Absent fifth toenail (HP:0200105). Evidence: PCS. Frequency: 3/3. (PMID:22426308)
- Global developmental delay (HP:0001263): A delay in the achievement of motor or mental milestones in the domains of development of a child, including motor skills, speech and language, cognitive skills, and social and emotional skills. This term should only be used to describe children younger than five years of age. Evidence: PCS. Frequency: 3/3. (PMID:22426308)
- Low anterior hairline (HP:0000294): Distance between the hairline (trichion) and the glabella (the most prominent point on the frontal bone above the root of the nose), in the midline, more than two SD below the mean. Alternatively, an apparently decreased distance between the hairline and the glabella. Evidence: PCS. Frequency: 1/1. (PMID:23906836)
- Absent fifth fingernail (HP:0200104): Absence of nail of little finger. Evidence: PCS. Frequency: 3/3. (PMID:22426308)
- Long eyelashes (HP:0000527): Mid upper eyelash length >10 mm or increased length of the eyelashes (subjective). Evidence: PCS. Frequency: 4/4. (PMID:22426308;PMID:23906836)
- Sandal gap (HP:0001852): A widely spaced gap between the first toe (the great toe) and the second toe. Evidence: PCS. Frequency: 1/1. (PMID:23906836)
- Short philtrum (HP:0000322): Distance between nasal base and midline upper lip vermilion border more than 2 SD below the mean. Alternatively, an apparently decreased distance between nasal base and midline upper lip vermilion border. Evidence: PCS. Frequency: 2/4. (PMID:22426308;PMID:23906836)
- Autosomal dominant inheritance (HP:0000006): A mode of inheritance that is observed for traits related to a gene encoded on one of the autosomes (i.e., the human chromosomes 1-22) in which a trait manifests in heterozygotes. In the context of medical genetics, an autosomal dominant disorder is caused when a single copy of the mutant allele is present. Males and females are affected equally, and can both transmit the disorder with a risk of 50% for each child of inheriting the mutant allele. Evidence: PCS. (PMID:22426308)
- Wide nose (HP:0000445): Interalar distance more than two standard deviations above the mean for age, i.e., an apparently increased width of the nasal base and alae. Evidence: PCS. Frequency: 3/4. (PMID:22426308;PMID:23906836)
- Small nail (HP:0001792): A nail that is diminished in length and width, i.e., underdeveloped nail. Evidence: PCS. Frequency: 4/4. (PMID:22426308;PMID:23906836)
- Long philtrum (HP:0000343): Distance between nasal base and midline upper lip vermilion border more than 2 SD above the mean. Alternatively, an apparently increased distance between nasal base and midline upper lip vermilion border. Evidence: PCS. Frequency: 1/4. (PMID:22426308;PMID:23906836)
- Anteverted nares (HP:0000463): Anteriorly-facing nostrils viewed with the head in the Frankfurt horizontal and the eyes of the observer level with the eyes of the subject. This gives the appearance of an upturned nose (upturned nasal tip). Evidence: PCS. Frequency: 1/1. (PMID:23906836)
- Brachydactyly (HP:0001156): Digits that appear disproportionately short compared to the hand/foot. The word brachydactyly is used here to describe a series distinct patterns of shortened digits (brachydactyly types A-E). This is the sense used here. Evidence: TAS. (OMIM:614607)
- Inguinal hernia (HP:0000023): Protrusion of the contents of the abdominal cavity through the inguinal canal. Evidence: PCS. Frequency: 1/3. (PMID:22426308)
- Abnormal corpus callosum morphology (HP:0001273): Abnormality of the corpus callosum. Evidence: TAS. Frequency: 3/3. (OMIM:614607)
- Recurrent infections (HP:0002719): Increased susceptibility to infections as manifested by repeated bouts of infection. Evidence: PCS. Frequency: 3/4. (PMID:22426308;PMID:23906836)
- Short distal phalanx of finger (HP:0009882): Short distance from the end of the finger to the most distal interphalangeal crease or the distal interphalangeal joint flexion point. That is, hypoplasia of one or more of the distal phalanx of finger. Evidence: PCS. Frequency: 1/1. (PMID:23906836)
- Dandy-Walker malformation (HP:0001305): A congenital brain malformation typically characterized by incomplete formation of the cerebellar vermis, dilation of the fourth ventricle, and enlargement of the posterior fossa. In layman's terms, Dandy Walker malformation is a cyst in the cerebellum (typically symmetrical) that is involved with the fourth ventricle. This may interfere with the ability to drain cerebrospinal fluid from the brain, resulting in hydrocephalus. Dandy Walker cysts are formed during early embryonic development, while the brain forms. The cyst in the cerebellum typically has several blood vessels running through it connecting to the brain, thereby prohibiting surgical removal. Evidence: PCS. Frequency: 1/3. Onset: Congenital onset (HP:0003577). (PMID:22426308)
- Abnormal heart morphology (HP:0001627): Any structural anomaly of the heart. Evidence: PCS. Frequency: 0/1. (PMID:23906836)
- High palate (HP:0000218): Height of the palate more than 2 SD above the mean (objective) or palatal height at the level of the first permanent molar more than twice the height of the teeth (subjective). Evidence: PCS. Frequency: 2/3. (PMID:22426308)
- Abnormal pinna morphology (HP:0000377): An abnormality of the pinna, which is also referred to as the auricle or external ear. Evidence: PCS. Frequency: 1/1. (PMID:23906836)
- Thick lower lip vermilion (HP:0000179): Increased thickness of the lower lip, leading to a prominent appearance of the lower lip. The height of the vermilion of the lower lip in the midline is more than 2 SD above the mean. Alternatively, an apparently increased height of the vermilion of the lower lip in the frontal view (subjective). Evidence: PCS. Frequency: 1/1. (PMID:23906836)
- Wide mouth (HP:0000154): Distance between the oral commissures more than 2 SD above the mean. Alternatively, an apparently increased width of the oral aperture (subjective). Evidence: PCS. Frequency: 4/4. (PMID:22426308;PMID:23906836)
- Delayed speech and language development (HP:0000750): A degree of language development that is significantly below the norm for a child of a specified age. Evidence: PCS. Frequency: 1/1. (PMID:23906836)
- Cerebellar hypoplasia (HP:0001321): Cerebellar hypoplasia is a descriptive term implying a cerebellum with a reduced volume, but a normal shape and is stable over time. Evidence: PCS. Frequency: 1/2. (PMID:22426308)
- Depressed nasal bridge (HP:0005280): Posterior positioning of the nasal root in relation to the overall facial profile for age. Evidence: PCS. Frequency: 3/4. (PMID:22426308;PMID:23906836)
- Ptosis (HP:0000508): The upper eyelid margin is positioned 3 mm or more lower than usual and covers the superior portion of the iris (objective); or, the upper lid margin obscures at least part of the pupil (subjective). Evidence: PCS. Frequency: 1/1. (PMID:23906836)
- Sparse scalp hair (HP:0002209): Decreased number of hairs per unit area of skin of the scalp. Evidence: PCS. Frequency: 3/3. (PMID:22426308)
- Visual impairment (HP:0000505): Visual impairment (or vision impairment) is vision loss (of a person) to such a degree as to qualify as an additional support need through a significant limitation of visual capability resulting from either disease, trauma, or congenital or degenerative conditions that cannot be corrected by conventional means, such as refractive correction, medication, or surgery. Evidence: PCS. Frequency: 1/2. (PMID:22426308)
- Intrauterine growth retardation (HP:0001511): An abnormal restriction of fetal growth with fetal weight below the tenth percentile for gestational age. Evidence: PCS. Frequency: 1/3. (PMID:22426308)
- Cryptorchidism (HP:0000028): Testis in inguinal canal. That is, absence of one or both testes from the scrotum owing to failure of the testis or testes to descend through the inguinal canal to the scrotum. Evidence: PCS. Frequency: 1/1. (PMID:23906836)
These phenotypes are associated with the disease intellectual disability, autosomal dominant 14 (OMIM:614607).